Phenotypes associated with the disease Mucolipidosis type III (ORPHA:577):
- Genu valgum (HP:0002857): The legs angle inward, such that the knees are close together and the ankles far apart. Evidence: TAS. Frequency: Frequent (HP:0040282). (ORPHA:577)
- Hyperlordosis (HP:0003307): Abnormally increased curvature (anterior concavity) of the lumbar or cervical spine. Evidence: TAS. Frequency: Frequent (HP:0040282). (ORPHA:577)
- Corneal opacity (HP:0007957): A reduction of corneal clarity. Evidence: TAS. Frequency: Frequent (HP:0040282). (ORPHA:577)
- Prominent occiput (HP:0000269): Increased convexity of the occiput (posterior part of the skull). Evidence: TAS. Frequency: Very frequent (HP:0040281). (ORPHA:577)
- Visual impairment (HP:0000505): Visual impairment (or vision impairment) is vision loss (of a person) to such a degree as to qualify as an additional support need through a significant limitation of visual capability resulting from either disease, trauma, or congenital or degenerative conditions that cannot be corrected by conventional means, such as refractive correction, medication, or surgery. Evidence: TAS. Frequency: Very frequent (HP:0040281). (ORPHA:577)
- Joint stiffness (HP:0001387): Joint stiffness is a perceived sensation of tightness in a joint or joints when attempting to move them after a period of inactivity. Joint stiffness typically subsides over time. Evidence: TAS. Frequency: Very frequent (HP:0040281). (ORPHA:577)
- Deficiency of N-acetylglucosamine-1-phosphotransferase (HP:0003264). Evidence: TAS. Frequency: Very frequent (HP:0040281). (ORPHA:577)
- Abnormal hip bone morphology (HP:0003272): An abnormality of the hip bone. Evidence: TAS. Frequency: Very frequent (HP:0040281). (ORPHA:577)
- Abnormal vertebral body morphology (HP:0003312): Abnormal form of vertebral body, which is the central cylindrical portion of the vertebra that together with other structures such as the vertebral arch, pedicles, laminae, spinous process, transverse processes, and articular facets makes up a vertebra. Evidence: TAS. Frequency: Very frequent (HP:0040281). (ORPHA:577)
- Short stature (HP:0004322): A height below that which is expected according to age and gender norms. Although there is no universally accepted definition of short stature, many refer to "short stature" as height more than 2 standard deviations below the mean for age and gender (or below the 3rd percentile for age and gender dependent norms). Evidence: TAS. Frequency: Very frequent (HP:0040281). (ORPHA:577)
- Craniofacial hyperostosis (HP:0004493): Excessive growth of the craniofacial bones. Evidence: TAS. Frequency: Very frequent (HP:0040281). (ORPHA:577)
- Large iliac wing (HP:0008818): Increased size of the ilium ala. Evidence: TAS. Frequency: Very frequent (HP:0040281). (ORPHA:577)
- Hypoplastic inferior ilia (HP:0008821). Evidence: TAS. Frequency: Very frequent (HP:0040281). (ORPHA:577)
- Stiff finger (HP:0025261): A sensation of tightness in a finger joint when attempting to move it, especially after a period of inactivity. Evidence: TAS. Frequency: Very frequent (HP:0040281). (ORPHA:577)
- Coarse facial features (HP:0000280): Absence of fine and sharp appearance of brows, nose, lips, mouth, and chin, usually because of rounded and heavy features or thickened skin with or without thickening of subcutaneous and bony tissues. Evidence: TAS. Frequency: Frequent (HP:0040282). (ORPHA:577)
- Osteopenia (HP:0000938): Osteopenia is a term to define bone density that is not normal but also not as low as osteoporosis. By definition from the World Health Organization osteopenia is defined by bone densitometry as a T score -1 to -2.5. Evidence: TAS. Frequency: Frequent (HP:0040282). (ORPHA:577)
- Dysostosis multiplex (HP:0000943). Evidence: TAS. Frequency: Frequent (HP:0040282). (ORPHA:577)
- Hip dysplasia (HP:0001385): The presence of developmental dysplasia of the hip. Evidence: TAS. Frequency: Frequent (HP:0040282). (ORPHA:577)
- Mitral valve prolapse (HP:0001634): One or both of the leaflets (cusps) of the mitral valve bulges back into the left atrium upon contraction of the left ventricle. Evidence: TAS. Frequency: Frequent (HP:0040282). (ORPHA:577)
- Scoliosis (HP:0002650): The presence of an abnormal lateral curvature of the spine. Evidence: TAS. Frequency: Frequent (HP:0040282). (ORPHA:577)
- Osteoarthritis (HP:0002758): Degeneration (wear and tear) of articular cartilage, i.e., of the joint surface. Joint degeneration may be accompanied by osteophytes (bone overgrowth), narrowing of the joint space, regions of sclerosis at the joint surface, or joint deformity. Evidence: TAS. Frequency: Frequent (HP:0040282). (ORPHA:577)
- Bullet-shaped distal phalanges of the hand (HP:0009837): Short and wide distal phalanges that taper distally. Bullet-shaped phalanges lack the normal diaphyseal constriction. Evidence: TAS. Frequency: Frequent (HP:0040282). (ORPHA:577)
- Constrictive median neuropathy (HP:0012185): Injury to the median nerve caused by its entrapment at the wrist as it traverses through the carpal tunnel. Clinically, constrictive median neuropathy is characterized by pain, paresthesia, and weakness in the median nerve distribution of the hand. Evidence: TAS. Frequency: Frequent (HP:0040282). (ORPHA:577)
- Chronic pain (HP:0012532): Persistent pain, usually defined as pain that has lasted longer than 3 to 6 months. Evidence: TAS. Frequency: Frequent (HP:0040282). (ORPHA:577)
- Abnormal cardiovascular system morphology (HP:0030680): Any structural anomaly of the heart and blood vessels. Evidence: TAS. Frequency: Frequent (HP:0040282). (ORPHA:577)
- Claw hand deformity (HP:0034337): An abnormality of the hand characterized by metacarpophalangeal (MCP) hyperextension and proximal interphalangeal (PIP) and distal interphalangeal (DIP) flexion. The position of the affected hand is said to resemble a claw. Evidence: TAS. Frequency: Frequent (HP:0040282). (ORPHA:577)
- Cognitive impairment (HP:0100543): Abnormal cognition is characterized by deficits in thinking, reasoning, or remembering. Evidence: TAS. Frequency: Frequent (HP:0040282). (ORPHA:577)
- Broad ribs (HP:0000885): Increased width of ribs. Evidence: TAS. Frequency: Occasional (HP:0040283). (ORPHA:577)
- Thickened skin (HP:0001072): Laminar thickening of skin. Evidence: TAS. Frequency: Occasional (HP:0040283). (ORPHA:577)
- Mitral regurgitation (HP:0001653): An abnormality of the mitral valve characterized by insufficiency or incompetence of the mitral valve resulting in retrograde leaking of blood through the mitral valve upon ventricular contraction. Evidence: TAS. Frequency: Occasional (HP:0040283). (ORPHA:577)
- Aortic regurgitation (HP:0001659): An insufficiency of the aortic valve, leading to regurgitation (backward flow) of blood from the aorta into the left ventricle. Evidence: TAS. Frequency: Occasional (HP:0040283). (ORPHA:577)
- Restrictive ventilatory defect (HP:0002091): A functional defect characterized by reduced total lung capacity (TLC) not associated with abnormalities of expiratory airflow or airway resistance. Spirometrically, a restrictive defect is defined as FEV1 (forced expiratory volume in 1 second) and FVC (forced vital capacity) less than 80 per cent. Restrictive lung disease may be caused by alterations in lung parenchyma or because of a disease of the pleura, chest wall, or neuromuscular apparatus. Evidence: TAS. Frequency: Occasional (HP:0040283). (ORPHA:577)
- Spinal cord compression (HP:0002176): External mechanical compression of the spinal cord. Evidence: TAS. Frequency: Occasional (HP:0040283). (ORPHA:577)
- Waddling gait (HP:0002515): Weakness of the hip girdle and upper thigh muscles, for instance in myopathies, leads to an instability of the pelvis on standing and walking. If the muscles extending the hip joint are affected, the posture in that joint becomes flexed and lumbar lordosis increases. The patients usually have difficulties standing up from a sitting position. Due to weakness in the gluteus medius muscle, the hip on the side of the swinging leg drops with each step (referred to as Trendelenburg sign). The gait appears waddling. The patients frequently attempt to counteract the dropping of the hip on the swinging side by bending the trunk towards the side which is in the stance phase (in the German language literature this is referred to as Duchenne sign). Similar gait patterns can be caused by orthopedic conditions when the origin and the insertion site of the gluteus medius muscle are closer to each other than normal, for instance due to a posttraumatic elevation of the trochanter or pseudarthrosis of the femoral neck. Evidence: TAS. Frequency: Occasional (HP:0040283). (ORPHA:577)
- Reduced bone mineral density (HP:0004349): A reduction of bone mineral density, that is, of the amount of matter per cubic centimeter of bones. Evidence: TAS. Frequency: Occasional (HP:0040283). (ORPHA:577)
- Fatigue (HP:0012378): A subjective feeling of tiredness characterized by a lack of energy and motivation. Evidence: TAS. Frequency: Occasional (HP:0040283). (ORPHA:577)